- Thin upper lip vermilion (HP:0000219): Height of the vermilion of the upper lip in the midline more than 2 SD below the mean. Alternatively, an apparently reduced height of the vermilion of the upper lip in the frontal view (subjective). Evidence: TAS. Frequency: Frequent (HP:0040282). (ORPHA:3164)
- Webbed neck (HP:0000465): Pterygium colli is a congenital skin fold that runs along the sides of the neck down to the shoulders. It involves an ectopic fibrotic facial band superficial to the trapezius muscle. Excess hair-bearing skin is also present and extends down the cervical region well beyond the normal hairline. Evidence: TAS. Frequency: Occasional (HP:0040283). (ORPHA:3164)
- Downslanted palpebral fissures (HP:0000494): The palpebral fissure inclination is more than two standard deviations below the mean. Evidence: TAS. Frequency: Frequent (HP:0040282). (ORPHA:3164)
- Abnormal eyelash morphology (HP:0000499): An abnormality of the eyelashes. Evidence: TAS. Frequency: Very frequent (HP:0040281). (ORPHA:3164)
- Telecanthus (HP:0000506): Distance between the inner canthi more than two standard deviations above the mean (objective); or, apparently increased distance between the inner canthi. Evidence: TAS. Frequency: Frequent (HP:0040282). (ORPHA:3164)
- Hypotonia (HP:0001252): Hypotonia is an abnormally low muscle tone (the amount of tension or resistance to movement in a muscle). Even when relaxed, muscles have a continuous and passive partial contraction which provides some resistance to passive stretching. Hypotonia thus manifests as diminished resistance to passive stretching. Hypotonia is not the same as muscle weakness, although the two conditions can co-exist. Evidence: TAS. Frequency: Very frequent (HP:0040281). (ORPHA:3164)
- Global developmental delay (HP:0001263): A delay in the achievement of motor or mental milestones in the domains of development of a child, including motor skills, speech and language, cognitive skills, and social and emotional skills. This term should only be used to describe children younger than five years of age. Evidence: TAS. Frequency: Very frequent (HP:0040281). (ORPHA:3164)
- Omphalocele (HP:0001539): A midline anterior incomplete closure of the abdominal wall in which there is herniation of the abdominal viscera into the base of the abdominal cord. Evidence: TAS. Frequency: Frequent (HP:0040282). (ORPHA:3164)
- Abnormally high-pitched voice (HP:0001620): A persistent (minutes to hours) abnormal increase in the pitch (frequency) of the voice for the context or social situation or significantly different from baseline of the individual. Evidence: TAS. Frequency: Very frequent (HP:0040281). (ORPHA:3164)
- Short columella (HP:0002000): Reduced distance from the anterior border of the naris to the subnasale. Evidence: TAS. Frequency: Frequent (HP:0040282). (ORPHA:3164)
- Gastroesophageal reflux (HP:0002020): A condition in which the stomach contents leak backwards from the stomach into the esophagus through the lower esophageal sphincter. Evidence: TAS. Frequency: Occasional (HP:0040283). (ORPHA:3164)
- Anal atresia (HP:0002023): Congenital absence of the anus, i.e., the opening at the bottom end of the intestinal tract. Evidence: TAS. Frequency: Occasional (HP:0040283). (ORPHA:3164)
- Chronic diarrhea (HP:0002028): The presence of chronic diarrhea, which is usually taken to mean diarrhea that has persisted for over 4 weeks. Evidence: TAS. Frequency: Occasional (HP:0040283). (ORPHA:3164)
- Neonatal respiratory distress (HP:0002643): Respiratory difficulty as newborn. Evidence: TAS. Frequency: Frequent (HP:0040282). (ORPHA:3164)
- Scoliosis (HP:0002650): The presence of an abnormal lateral curvature of the spine. Evidence: TAS. Frequency: Very frequent (HP:0040281). (ORPHA:3164)
- Downturned corners of mouth (HP:0002714): A morphological abnormality of the mouth in which the angle of the mouth is downturned. The oral commissures are positioned inferior to the midline labial fissure. Evidence: TAS. Frequency: Frequent (HP:0040282). (ORPHA:3164)
- Sparse lateral eyebrow (HP:0005338): Decreased density/number and/or decreased diameter of lateral eyebrow hairs. Evidence: TAS. Frequency: Very frequent (HP:0040281). (ORPHA:3164)
- Anteroposteriorly shortened larynx (HP:0005956): Abnormal shortening of the larynx in the anteroposterior (front to back) axis. Evidence: TAS. Frequency: Very frequent (HP:0040281). (ORPHA:3164)
- Laryngeal hypoplasia (HP:0008749): Underdevelopment of the larynx. Evidence: TAS. Frequency: Very frequent (HP:0040281). (ORPHA:3164)
- Feeding difficulties in infancy (HP:0008872): Impaired feeding performance of an infant as manifested by difficulties such as weak and ineffective sucking, brief bursts of sucking, and falling asleep during sucking. There may be difficulties with chewing or maintaining attention. Evidence: TAS. Frequency: Occasional (HP:0040283). (ORPHA:3164)
- Hypoplasia of the pharynx (HP:0009555): Underdevelopment of the pharynx. Evidence: TAS. Frequency: Very frequent (HP:0040281). (ORPHA:3164)
These phenotypes are associated with the disease Omphalocele syndrome, Shprintzen-Goldberg type (ORPHA:3164).